- Delayed speech and language development (HP:0000750): A degree of language development that is significantly below the norm for a child of a specified age. Evidence: IEA. (DECIPHER:43)
- Short attention span (HP:0000736): Reduced attention span characterized by distractibility and impulsivity. Evidence: IEA. (DECIPHER:43)
- Intellectual disability (HP:0001249): The term intellectual disability or intellectual developmental disorder is used to describe significantly sub-average intellectual and adaptive functioning based on clinical assessment and as measured by individually administered, appropriately normed, standardized and validated tests of intellectual functioning and adaptive behavior, with onset during the developmental period from infancy through adolescence. Evidence: IEA. (DECIPHER:43)
These phenotypes are associated with the disease 7q11.23 microduplication syndrome (DECIPHER:43).